- Juvenile onset (HP:0003621): Onset of signs or symptoms of disease between the age of 5 and 15 years. Evidence: PCS. Frequency: 1/16. (PMID:32337552)
- Childhood onset (HP:0011463): Onset of disease at the age of between 1 and 5 years. Evidence: PCS. Frequency: 1/16. (PMID:32337552)
- Sensorineural hearing impairment (HP:0000407): A type of hearing impairment in one or both ears related to an abnormal functionality of the cochlear nerve. Evidence: PCS. Frequency: 20/20. (PMID:32337552)
- Young adult onset (HP:0011462): Onset of disease at the age of between 16 and 40 years. Evidence: PCS. Frequency: 14/16. (PMID:32337552)
- Tinnitus (HP:0000360): Tinnitus is an auditory perception that can be described as the experience of sound, in the ear or in the head, in the absence of external acoustic stimulation. Evidence: PCS. Frequency: 15/19. (PMID:32337552)
- Reduced visual acuity (HP:0007663). Evidence: PCS. Frequency: 0/20. (PMID:32337552)
- Autosomal dominant inheritance (HP:0000006): A mode of inheritance that is observed for traits related to a gene encoded on one of the autosomes (i.e., the human chromosomes 1-22) in which a trait manifests in heterozygotes. In the context of medical genetics, an autosomal dominant disorder is caused when a single copy of the mutant allele is present. Males and females are affected equally, and can both transmit the disorder with a risk of 50% for each child of inheriting the mutant allele. Evidence: PCS. (PMID:32337552)
These phenotypes are associated with the disease autosomal dominant nonsyndromic hearing loss 58 (OMIM:615654).